Phenotypes associated with the disease autosomal dominant nonsyndromic hearing loss 36 (OMIM:606705):
- Juvenile onset (HP:0003621): Onset of signs or symptoms of disease between the age of 5 and 15 years. Evidence: PCS. (PMID:11850618)
- Sensorineural hearing impairment (HP:0000407): A type of hearing impairment in one or both ears related to an abnormal functionality of the cochlear nerve. Evidence: PCS. Onset: Juvenile onset (HP:0003621). (PMID:11850618)
- Tinnitus (HP:0000360): Tinnitus is an auditory perception that can be described as the experience of sound, in the ear or in the head, in the absence of external acoustic stimulation. Evidence: TAS. (OMIM:606705)
- Autosomal dominant inheritance (HP:0000006): A mode of inheritance that is observed for traits related to a gene encoded on one of the autosomes (i.e., the human chromosomes 1-22) in which a trait manifests in heterozygotes. In the context of medical genetics, an autosomal dominant disorder is caused when a single copy of the mutant allele is present. Males and females are affected equally, and can both transmit the disorder with a risk of 50% for each child of inheriting the mutant allele. Evidence: PCS. (PMID:11850618)